- Autosomal recessive inheritance (HP:0000007): A mode of inheritance that is observed for traits related to a gene encoded on one of the autosomes (i.e., the human chromosomes 1-22) in which a trait manifests in individuals with two pathogenic alleles, either homozygotes (two copies of the same mutant allele) or compound heterozygotes (whereby each copy of a gene has a distinct mutant allele). Evidence: IEA. (OMIM:212060)
- Drug-induced agranulocytosis (HP:0012235): Absence of detectable circulating granulocytes in the blood caused by an exposure to a drug. Usually a value of less than 50 granulocytes per microliter is considered to be an absence. Evidence: TAS. (OMIM:212060)
These phenotypes are associated with the disease Carbimazole sensitivity (OMIM:212060).